- Generalized hypertrichosis (HP:0004554): Generalized excessive, abnormal hairiness. Evidence: IEA. (OMIM:211770)
- Autosomal recessive inheritance (HP:0000007): A mode of inheritance that is observed for traits related to a gene encoded on one of the autosomes (i.e., the human chromosomes 1-22) in which a trait manifests in individuals with two pathogenic alleles, either homozygotes (two copies of the same mutant allele) or compound heterozygotes (whereby each copy of a gene has a distinct mutant allele). Evidence: IEA. (OMIM:211770)
- Lamellar cataract (HP:0007971): A congenital cataract in which opacity is limited to layers of the lens external to the nucleus (i.e., the perinuclear region), i.e., between the nuclear and cortical layers of the lens. Evidence: IEA. (OMIM:211770)
- Intellectual disability (HP:0001249): The term intellectual disability or intellectual developmental disorder is used to describe significantly sub-average intellectual and adaptive functioning based on clinical assessment and as measured by individually administered, appropriately normed, standardized and validated tests of intellectual functioning and adaptive behavior, with onset during the developmental period from infancy through adolescence. Evidence: IEA. (OMIM:211770)
These phenotypes are associated with the disease cataract-hypertrichosis-intellectual disability syndrome (OMIM:211770).